- Global developmental delay (HP:0001263): A delay in the achievement of motor or mental milestones in the domains of development of a child, including motor skills, speech and language, cognitive skills, and social and emotional skills. This term should only be used to describe children younger than five years of age. Evidence: TAS. Frequency: Very frequent (HP:0040281). (ORPHA:228426)
- Hepatosplenomegaly (HP:0001433): Simultaneous enlargement of the liver and spleen. Evidence: TAS. Frequency: Very frequent (HP:0040281). (ORPHA:228426)
- Failure to thrive in infancy (HP:0001531). Evidence: TAS. Frequency: Very frequent (HP:0040281). (ORPHA:228426)
- Abnormal facial shape (HP:0001999): An abnormal morphology (form) of the face or its components. Evidence: TAS. Frequency: Very frequent (HP:0040281). (ORPHA:228426)
- Relative macrocephaly (HP:0004482): A relatively mild degree of macrocephaly in which the head circumference is not above two standard deviations from the mean, but appears dysproportionately large when other factors such as body stature are taken into account. Evidence: TAS. Frequency: Very frequent (HP:0040281). (ORPHA:228426)
- Chronic lung disease (HP:0006528): According to the definitions of the American and British Thoracic Societies, including pulmonary functional tests, X-rays, and CT scans for items such as fibrosis, bronchiectasis, bullae, emphysema, nodular or lymphomatous abnormalities. Evidence: TAS. Frequency: Very frequent (HP:0040281). (ORPHA:228426)
- Proptosis (HP:0000520): An eye that is protruding anterior to the plane of the face to a greater extent than is typical. Evidence: TAS. Frequency: Frequent (HP:0040282). (ORPHA:228426)
- Hypothyroidism (HP:0000821): Deficiency of thyroid hormone. Evidence: TAS. Frequency: Frequent (HP:0040282). (ORPHA:228426)
- Hypersplenism (HP:0001971): A malfunctioning of the spleen in which it prematurely destroys red blood cells. Evidence: TAS. Frequency: Frequent (HP:0040282). (ORPHA:228426)
- Recurrent infections (HP:0002719): Increased susceptibility to infections as manifested by repeated bouts of infection. Evidence: TAS. Frequency: Frequent (HP:0040282). (ORPHA:228426)
- Autoimmunity (HP:0002960): The occurrence of an immune reaction against the organism's own cells or tissues. Evidence: TAS. Frequency: Frequent (HP:0040282). (ORPHA:228426)
- Floppy infant (HP:0008947): Floppiness/hypotonia is defined as reduced resistance to passive movement of joints. Physical examination of floppy/hypotonic infants shows head lag, lack of shoulder and elbow muscle contraction on traction response, inability to tighten the shoulder girdle muscles (or slipping through) when held under the axillae, scarf sign (when the arm is pulled to the opposite side, the arm wraps around the neck with the elbow crossing midline), hyperdorsiflexion of the feet, easy apposition of the thumb against the forearm, feet touching the cheek with ease and without discomfort, frog leg position, and inverted U sign on ventral suspension (head, arms, and legs hanging down without elbow or knee flexion and the trunk rounded in a dome shape). Evidence: TAS. Frequency: Frequent (HP:0040282). (ORPHA:228426)
- Gastrostomy tube feeding in infancy (HP:0011471): Feeding problem necessitating gastrostomy tube feeding. Evidence: TAS. Frequency: Frequent (HP:0040282). (ORPHA:228426)
- Hepatitis (HP:0012115): Inflammation of the liver. Evidence: TAS. Frequency: Frequent (HP:0040282). (ORPHA:228426)
- Anti-thyroid peroxidase antibody positivity (HP:0025379): The presence of autoantibodies (immunoglobulins) in the serum that react against thyroid peroxidase. Evidence: TAS. Frequency: Frequent (HP:0040282). (ORPHA:228426)
- Thyroiditis (HP:0100646): Inflammation of the thyroid gland. Evidence: TAS. Frequency: Frequent (HP:0040282). (ORPHA:228426)
- Dolichocephaly (HP:0000268): An abnormality of skull shape characterized by a increased anterior-posterior diameter, i.e., an increased antero-posterior dimension of the skull. Cephalic index less than 76%. Alternatively, an apparently increased antero-posterior length of the head compared to width. Often due to premature closure of the sagittal suture. Evidence: TAS. Frequency: Occasional (HP:0040283). (ORPHA:228426)
- Prominent occiput (HP:0000269): Increased convexity of the occiput (posterior part of the skull). Evidence: TAS. Frequency: Occasional (HP:0040283). (ORPHA:228426)
- Short chin (HP:0000331): Decreased vertical distance from the vermilion border of the lower lip to the inferior-most point of the chin. Evidence: TAS. Frequency: Occasional (HP:0040283). (ORPHA:228426)
- Posteriorly rotated ears (HP:0000358): A type of abnormal location of the ears in which the position of the ears is characterized by posterior rotation (the superior part of the ears is rotated towards the back of the head, and the inferior part of the ears towards the front). Evidence: TAS. Frequency: Occasional (HP:0040283). (ORPHA:228426)
- Choanal atresia (HP:0000453): Absence or abnormal closure of the choana (the posterior nasal aperture). Most embryologists believe that posterior choanal atresia results from a failure of rupture between the 35th and 38th day of fetal life of the partition which separates the bucconasal or buccopharyngeal membranes. The resultant choanal atresia may be unilateral or bilateral, bony or membranous, complete or incomplete. In over 90 per cent of cases the obstruction is bony, while in the remainder it is membranous. The bony type of atresia is commonly located 1-2 mm. anterior to the posterior edge of the hard palate, and the osseous septum varies in thickness from 1 to 10 mm. In the membranous form of choanal atresia the obstruction usually occurs further posteriorly. In approximately one third of cases the atresia is bilateral. Evidence: TAS. Frequency: Occasional (HP:0040283). (ORPHA:228426)
- Ptosis (HP:0000508): The upper eyelid margin is positioned 3 mm or more lower than usual and covers the superior portion of the iris (objective); or, the upper lid margin obscures at least part of the pupil (subjective). Evidence: TAS. Frequency: Occasional (HP:0040283). (ORPHA:228426)
- Cirrhosis (HP:0001394): A chronic disorder of the liver in which liver tissue becomes scarred and is partially replaced by regenerative nodules and fibrotic tissue resulting in loss of liver function. Evidence: TAS. Frequency: Occasional (HP:0040283). (ORPHA:228426)
- Portal hypertension (HP:0001409): Increased pressure in the portal vein. Evidence: TAS. Frequency: Occasional (HP:0040283). (ORPHA:228426)
- Pancytopenia (HP:0001876): An abnormal reduction in numbers of all blood cell types (red blood cells, white blood cells, and platelets). Evidence: TAS. Frequency: Occasional (HP:0040283). (ORPHA:228426)
- Autoimmune neutropenia (HP:0001904): Abnormal decrease of the absolute number of neutrophils in the blood, per microlitre, compared to a reference range for a given sex and age-group, accompanied by the detection of anti-neutrophil antibodies. Evidence: TAS. Frequency: Occasional (HP:0040283). (ORPHA:228426)
- Frontal bossing (HP:0002007): Bilateral bulging of the lateral frontal bone prominences with relative sparing of the midline. Evidence: TAS. Frequency: Occasional (HP:0040283). (ORPHA:228426)
- Abnormal intestine morphology (HP:0002242): An abnormality of the intestine. The closely related term enteropathy is used to refer to any disease of the intestine. Evidence: TAS. Frequency: Occasional (HP:0040283). (ORPHA:228426)
- Anti-smooth muscle antibody positivity (HP:0003262): The presence in serum of antibodies against smooth muscle. Evidence: TAS. Frequency: Occasional (HP:0040283). (ORPHA:228426)
- Antineutrophil antibody positivity (HP:0003453): The presence of autoantibodies in the serum that react against neutrophils. Evidence: TAS. Frequency: Occasional (HP:0040283). (ORPHA:228426)
- Acute hepatic failure (HP:0006554): Hepatic failure refers to the inability of the liver to perform its normal synthetic and metabolic functions, which can result in coagulopathy and alteration in the mental status of a previously healthy individual. Hepatic failure is defined as acute if there is onset of encephalopathy within 8 weeks of the onset of symptoms in a patient with a previously healthy liver. Evidence: TAS. Frequency: Occasional (HP:0040283). (ORPHA:228426)
- Midface retrusion (HP:0011800): Posterior positions and/or vertical shortening of the infraorbital and perialar regions, or increased concavity of the face and/or reduced nasolabial angle. Evidence: TAS. Frequency: Occasional (HP:0040283). (ORPHA:228426)
- Camptodactyly (HP:0012385): The distal interphalangeal joint and/or the proximal interphalangeal joint of the fingers or toes cannot be extended to 180 degrees by either active or passive extension. Evidence: TAS. Frequency: Occasional (HP:0040283). (ORPHA:228426)
- Anti-glutamic acid decarboxylase antibody positivity (HP:0025329): The presence of autoantibodies (immunoglobulins) in the serum that react against glutamic acid decarboxylase. Evidence: TAS. Frequency: Occasional (HP:0040283). (ORPHA:228426)
- Clinodactyly (HP:0030084): An angulation of a digit at an interphalangeal joint in the plane of the palm (finger) or sole (toe). Evidence: TAS. Frequency: Occasional (HP:0040283). (ORPHA:228426)
- Cholangitis (HP:0030151): Inflammation of the biliary ductal system, affecting the intrahepatic or extrahepatic portions, or both. Evidence: TAS. Frequency: Occasional (HP:0040283). (ORPHA:228426)
- Insulin receptor antibody positivity (HP:0031104): The presence of autoantibodies (immunoglobulins) in the serum that react against the insulin receptor. Evidence: TAS. Frequency: Occasional (HP:0040283). (ORPHA:228426)
- Type I diabetes mellitus (HP:0100651): A chronic condition in which the pancreas produces little or no insulin. Type I diabetes mellitus is manifested by the sudden onset of severe hyperglycemia with rapid progression to diabetic ketoacidosis unless treated with insulin. Evidence: TAS. Frequency: Occasional (HP:0040283). (ORPHA:228426)
These phenotypes are associated with the disease Syndromic multisystem autoimmune disease due to Itch deficiency (ORPHA:228426).